Phenotypes associated with the disease migraine without aura, susceptibility to, 4 (OMIM:607501):
- Vomiting (HP:0002013): Forceful ejection of the contents of the stomach through the mouth by means of a series of involuntary spasmic contractions. Evidence: IEA. (OMIM:607501)
- Photophobia (HP:0000613): Excessive sensitivity to light with the sensation of discomfort or pain in the eyes due to exposure to bright light. Evidence: IEA. (OMIM:607501)
- Migraine without aura (HP:0002083): Repeated headache attacks lasting 4-72 h fulfilling at least two of the following criteria: 1) unilateral location, 2) pulsating quality, 3) moderate or severe pain intensity, and 4) aggravation by or causing avoidance of routine physical activity such as climbing stairs. Headache attacks are commonly accompanied by nausea, vomiting, photophobia, or phonophobia. Evidence: IEA. (OMIM:607501)
- Phonophobia (HP:0002183): An abnormally heightened sensitivity to loud sounds. Evidence: IEA. (OMIM:607501)
- Nausea (HP:0002018): A sensation of unease in the stomach together with an urge to vomit. Evidence: IEA. (OMIM:607501)
- Autosomal dominant inheritance (HP:0000006): A mode of inheritance that is observed for traits related to a gene encoded on one of the autosomes (i.e., the human chromosomes 1-22) in which a trait manifests in heterozygotes. In the context of medical genetics, an autosomal dominant disorder is caused when a single copy of the mutant allele is present. Males and females are affected equally, and can both transmit the disorder with a risk of 50% for each child of inheriting the mutant allele. Evidence: IEA. (OMIM:607501)
- Hyperreflexia (HP:0001347): Hyperreflexia is the presence of hyperactive stretch reflexes of the muscles. Evidence: IEA. (OMIM:607501)